- Deficient excision of UV-induced pyrimidine dimers in DNA (HP:0003213). Evidence: IEA. (OMIM:227650)
- Prolonged G2 phase of cell cycle (HP:0003214). Evidence: IEA. (OMIM:227650)
- Hearing impairment (HP:0000365): A decreased magnitude of the sensory perception of sound. Evidence: IEA. (OMIM:227650)
- Strabismus (HP:0000486): A misalignment of the eyes so that the visual axes deviate from bifoveal fixation. The classification of strabismus may be based on a number of features including the relative position of the eyes, whether the deviation is latent or manifest, intermittent or constant, concomitant or otherwise and according to the age of onset and the relevance of any associated refractive error. Evidence: IEA. (OMIM:227650)
- Short stature (HP:0004322): A height below that which is expected according to age and gender norms. Although there is no universally accepted definition of short stature, many refer to "short stature" as height more than 2 standard deviations below the mean for age and gender (or below the 3rd percentile for age and gender dependent norms). Evidence: IEA. (OMIM:227650)
- Ectopic kidney (HP:0000086): A developmental defect in which a kidney is located in an abnormal anatomic position. Evidence: IEA. (OMIM:227650)
- Male infertility (HP:0003251). Evidence: TAS. Frequency: Very rare (HP:0040284). (PMID:29904161)
- Horseshoe kidney (HP:0000085): A connection of the right and left kidney by an isthmus of functioning renal parenchyma or fibrous tissue that crosses the midline. Evidence: IEA. (OMIM:227650)
- Duplicated collecting system (HP:0000081): A duplication of the collecting system of the kidney, defined as a kidney with two (instead of, normally, one) pyelocaliceal systems. The pyelocaliceal system is comprised of the renal pelvis and calices. The duplicated renal collecting system can be associated with a single ureter or with double ureters. In the latter case, the two ureters empty separately into the bladder or fuse to form a single ureteral orifice. Evidence: IEA. (OMIM:227650)
- Abnormal renal morphology (HP:0012210): Any structural anomaly of the kidney. Evidence: IEA. (OMIM:227650)
- Leukemia (HP:0001909): A cancer of the blood and bone marrow characterized by an abnormal proliferation of leukocytes. Evidence: IEA. (OMIM:227650)
- Hypergonadotropic hypogonadism (HP:0000815): Reduced function of the gonads (testes in males or ovaries in females) associated with excess pituitary gonadotropin secretion and resulting in delayed sexual development and growth delay. Evidence: IEA. (OMIM:227650)
- Cafe-au-lait spot (HP:0000957): Cafe-au-lait spots are hyperpigmented lesions that can vary in color from light brown to dark brown with smooth borders and having a size of 1.5 cm or more in adults and 0.5 cm or more in children. Evidence: IEA. (OMIM:227650)
- Anemia (HP:0001903): A reduction in erythrocytes volume or hemoglobin concentration. Evidence: TAS. (OMIM:227650)
- Abnormal cardiovascular system morphology (HP:0030680): Any structural anomaly of the heart and blood vessels. Evidence: IEA. (OMIM:227650)
- Bruising susceptibility (HP:0000978): An ecchymosis (bruise) refers to the skin discoloration caused by the escape of blood into the tissues from ruptured blood vessels. This term refers to an abnormally increased susceptibility to bruising. The corresponding phenotypic abnormality is generally elicited on medical history as a report of frequent ecchymoses or bruising without adequate trauma. Evidence: IEA. (OMIM:227650)
- Abnormal heart morphology (HP:0001627): Any structural anomaly of the heart. Evidence: TAS. (OMIM:227650)
- Complete duplication of thumb phalanx (HP:0009943): A complete duplication affecting one or more of the phalanges of the thumb. As opposed to a partial duplication were there is still a variable degree of fusion between the duplicated bones, a complete duplication leads to two separate bones appearing side to side (radio-ulnar axis) as seen on x-rays. A duplication leading to an accessory bone appearing in the proximo-distal axis on x-rays, this is actually a different entity called a Pseudoepiphyses (see according terms) sometimes also referred to as Hyperphalangism. Evidence: IEA. (OMIM:227650)
- Intellectual disability (HP:0001249): The term intellectual disability or intellectual developmental disorder is used to describe significantly sub-average intellectual and adaptive functioning based on clinical assessment and as measured by individually administered, appropriately normed, standardized and validated tests of intellectual functioning and adaptive behavior, with onset during the developmental period from infancy through adolescence. Evidence: IEA. (OMIM:227650)
- Microcephaly (HP:0000252): Head circumference below 2 standard deviations below the mean for age and gender. Evidence: IEA. (OMIM:227650)
- Abnormal skin pigmentation (HP:0001000): An abnormality of the pigmentation of the skin. Evidence: TAS. (OMIM:227650)
- Chromosomal breakage induced by crosslinking agents (HP:0003221): Increased amount of chromosomal breaks in cultured blood lymphocytes or other cells induced by treatment with DNA cross-linking agents such as diepoxybutane and mitomycin C. Evidence: IEA. (OMIM:227650)
- Small for gestational age (HP:0001518): Smaller than normal size according to sex and gestational age related norms, defined as a weight below the 10th percentile for the gestational age. Evidence: IEA. (OMIM:227650)
- Microphthalmia (HP:0000568): A developmental anomaly characterized by abnormal smallness of one or both eyes. Evidence: IEA. (OMIM:227650)
- Autosomal recessive inheritance (HP:0000007): A mode of inheritance that is observed for traits related to a gene encoded on one of the autosomes (i.e., the human chromosomes 1-22) in which a trait manifests in individuals with two pathogenic alleles, either homozygotes (two copies of the same mutant allele) or compound heterozygotes (whereby each copy of a gene has a distinct mutant allele). Evidence: TAS. (OMIM:227650)
- Absent thumb (HP:0009777): Absent thumb, i.e., the absence of both phalanges of a thumb and the associated soft tissues. Evidence: IEA. (OMIM:227650)
- Reticulocytopenia (HP:0001896): A reduced number of reticulocytes in the peripheral blood. Evidence: IEA. (OMIM:227650)
- Short thumb (HP:0009778): Hypoplasia (congenital reduction in size) of the thumb. Evidence: IEA. (OMIM:227650)
- Thrombocytopenia (HP:0001873): A reduction in the number of circulating thrombocytes. Evidence: TAS. (OMIM:227650)
- Cryptorchidism (HP:0000028): Testis in inguinal canal. That is, absence of one or both testes from the scrotum owing to failure of the testis or testes to descend through the inguinal canal to the scrotum. Evidence: IEA. (OMIM:227650)
- Pancytopenia (HP:0001876): An abnormal reduction in numbers of all blood cell types (red blood cells, white blood cells, and platelets). Evidence: IEA. (OMIM:227650)
- Absent radius (HP:0003974): Missing radius bone associated with congenital failure of development. Evidence: IEA. (OMIM:227650)
- Renal agenesis (HP:0000104): Agenesis, that is, failure of the kidney to develop during embryogenesis and development. Evidence: IEA. (OMIM:227650)
- Anemic pallor (HP:0001017): A type of pallor that is secondary to the presence of anemia. Evidence: IEA. (OMIM:227650)
- Decreased total neutrophil count (HP:0001875): Abnormal decrease of absolute number of neutrophils in the blood, per microlitre, compared to a reference range for a given sex and age-group. Evidence: IEA. (OMIM:227650)
These phenotypes are associated with the disease Fanconi anemia complementation group A (OMIM:227650).